- Nodular inflammatory vasculitis (HP:0005300). Evidence: IEA. (OMIM:192310)
- Abnormality of metabolism/homeostasis (HP:0001939). Evidence: IEA. (OMIM:192310)
- Autosomal dominant inheritance (HP:0000006): A mode of inheritance that is observed for traits related to a gene encoded on one of the autosomes (i.e., the human chromosomes 1-22) in which a trait manifests in heterozygotes. In the context of medical genetics, an autosomal dominant disorder is caused when a single copy of the mutant allele is present. Males and females are affected equally, and can both transmit the disorder with a risk of 50% for each child of inheriting the mutant allele. Evidence: IEA. (OMIM:192310)
These phenotypes are associated with the disease vasculitis, lymphocytic, nodular (OMIM:192310).